- Glaucoma (HP:0000501): Glaucoma refers loss of retinal ganglion cells in a characteristic pattern of optic neuropathy usually associated with increased intraocular pressure. Evidence: TAS. Frequency: Very frequent (HP:0040281). (ORPHA:2818)
- Intellectual disability (HP:0001249): The term intellectual disability or intellectual developmental disorder is used to describe significantly sub-average intellectual and adaptive functioning based on clinical assessment and as measured by individually administered, appropriately normed, standardized and validated tests of intellectual functioning and adaptive behavior, with onset during the developmental period from infancy through adolescence. Evidence: TAS. Frequency: Very frequent (HP:0040281). (ORPHA:2818)
- Spasticity (HP:0001257): A motor disorder characterized by a velocity-dependent increase in tonic stretch reflexes with increased muscle tone, exaggerated (hyperexcitable) tendon reflexes. Evidence: TAS. Frequency: Very frequent (HP:0040281). (ORPHA:2818)
- Paraplegia (HP:0010550): Severe or complete weakness of both lower extremities with sparing of the upper extremities. Evidence: TAS. Frequency: Very frequent (HP:0040281). (ORPHA:2818)
These phenotypes are associated with the disease Spastic paraplegia-glaucoma-intellectual disability syndrome (ORPHA:2818).